Phenotypes associated with the disease nephronophthisis 12 (OMIM:613820):
- Stage 5 chronic kidney disease (HP:0003774): A degree of kidney failure severe enough to require dialysis or kidney transplantation for survival characterized by a severe reduction in glomerular filtration rate (less than 15 ml/min/1.73 m2) and other manifestations including increased serum creatinine. Evidence: PCS. (PMID:21258341)
- Autosomal recessive inheritance (HP:0000007): A mode of inheritance that is observed for traits related to a gene encoded on one of the autosomes (i.e., the human chromosomes 1-22) in which a trait manifests in individuals with two pathogenic alleles, either homozygotes (two copies of the same mutant allele) or compound heterozygotes (whereby each copy of a gene has a distinct mutant allele). Evidence: PCS. (PMID:21258341)
- Nephronophthisis (HP:0000090): Presence of cysts at the corticomedullary junction of the kidney in combination with tubulointerstitial fibrosis. Evidence: PCS. (PMID:21258341)
- Autosomal dominant inheritance (HP:0000006): A mode of inheritance that is observed for traits related to a gene encoded on one of the autosomes (i.e., the human chromosomes 1-22) in which a trait manifests in heterozygotes. In the context of medical genetics, an autosomal dominant disorder is caused when a single copy of the mutant allele is present. Males and females are affected equally, and can both transmit the disorder with a risk of 50% for each child of inheriting the mutant allele. Evidence: TAS. (OMIM:613820)